- Macrodontia of permanent maxillary central incisor (HP:0000675): Increased size of the maxillary central secondary incisor tooth. Evidence: IEA. (OMIM:147300)
- Autosomal dominant inheritance (HP:0000006): A mode of inheritance that is observed for traits related to a gene encoded on one of the autosomes (i.e., the human chromosomes 1-22) in which a trait manifests in heterozygotes. In the context of medical genetics, an autosomal dominant disorder is caused when a single copy of the mutant allele is present. Males and females are affected equally, and can both transmit the disorder with a risk of 50% for each child of inheriting the mutant allele. Evidence: IEA. (OMIM:147300)
These phenotypes are associated with the disease INCISORS, LONG UPPER CENTRAL (OMIM:147300).